Phenotypes associated with the disease Babesiosis (ORPHA:108):
- Renal insufficiency (HP:0000083): A reduction in the level of performance of the kidneys in areas of function comprising the concentration of urine, removal of wastes, the maintenance of electrolyte balance, homeostasis of blood pressure, and calcium metabolism. Evidence: TAS. Frequency: Occasional (HP:0040283). (ORPHA:108)
- Photophobia (HP:0000613): Excessive sensitivity to light with the sensation of discomfort or pain in the eyes due to exposure to bright light. Evidence: TAS. Frequency: Occasional (HP:0040283). (ORPHA:108)
- Depression (HP:0000716): Frequently experiencing feelings of being down, miserable, and/or hopeless; struggling to recover from these moods; having a pessimistic outlook on the future; feeling a pervasive sense of shame; having a low self-worth; experiencing thoughts of suicide and engaging in suicidal behavior. Evidence: TAS. Frequency: Occasional (HP:0040283). (ORPHA:108)
- Jaundice (HP:0000952): Yellow pigmentation of the skin due to bilirubin, which in turn is the result of increased bilirubin concentration in the bloodstream. Evidence: TAS. Frequency: Frequent (HP:0040282). (ORPHA:108)
- Hyperhidrosis (HP:0000975): Abnormal excessive perspiration (sweating) despite the lack of appropriate stimuli like hot and humid weather. Evidence: TAS. Frequency: Frequent (HP:0040282). (ORPHA:108)
- Coma (HP:0001259): The complete absence of wakefulness and consciousness, which is evident through a lack of response to any form of external stimuli. Evidence: TAS. Frequency: Occasional (HP:0040283). (ORPHA:108)
- Confusion (HP:0001289): Lack of clarity and coherence of thought, perception, understanding, or action. Evidence: TAS. Frequency: Occasional (HP:0040283). (ORPHA:108)
- Limitation of joint mobility (HP:0001376): A reduction in the freedom of movement of one or more joints. Evidence: TAS. Frequency: Occasional (HP:0040283). (ORPHA:108)
- Hepatic failure (HP:0001399). Evidence: TAS. Frequency: Occasional (HP:0040283). (ORPHA:108)
- Congestive heart failure (HP:0001635): The presence of an abnormality of cardiac function that is responsible for the failure of the heart to pump blood at a rate that is commensurate with the needs of the tissues or a state in which abnormally elevated filling pressures are required for the heart to do so. Heart failure is frequently related to a defect in myocardial contraction. Evidence: TAS. Frequency: Occasional (HP:0040283). (ORPHA:108)
- Myocardial infarction (HP:0001658): Necrosis of the myocardium caused by an obstruction of the blood supply to the heart and often associated with chest pain, shortness of breath, palpitations, and anxiety as well as characteristic EKG findings and elevation of serum markers including creatine kinase-MB fraction and troponin. Evidence: TAS. Frequency: Occasional (HP:0040283). (ORPHA:108)
- Splenomegaly (HP:0001744): Abnormal increased size of the spleen. Evidence: TAS. Frequency: Frequent (HP:0040282). (ORPHA:108)
- Clinodactyly of the 5th toe (HP:0001864): Bending or curvature of a fifth toe in the tibial direction (i.e., towards the big toe). Evidence: TAS. Frequency: Occasional (HP:0040283). (ORPHA:108)
- Thrombocytopenia (HP:0001873): A reduction in the number of circulating thrombocytes. Evidence: TAS. Frequency: Frequent (HP:0040282). (ORPHA:108)
- Hemolytic anemia (HP:0001878): A type of anemia caused by premature destruction of red blood cells (hemolysis). Evidence: TAS. Frequency: Very frequent (HP:0040281). (ORPHA:108)
- Decreased total leukocyte count (HP:0001882): An abnormal decreased number of leukocytes in the blood. Evidence: TAS. Frequency: Frequent (HP:0040282). (ORPHA:108)
- Fever (HP:0001945): Body temperature elevated above the normal range. Evidence: TAS. Frequency: Very frequent (HP:0040281). (ORPHA:108)
- Nausea and vomiting (HP:0002017): Nausea is a commonly encountered symptom that has been defined as an unpleasant painless subjective feeling that one will imminently vomit. Vomiting has been defined as the forceful expulsion of the contents of the stomach, duodenum, or jejunum through the oral cavity. While nausea and vomiting are often thought to exist on a temporal continuum, this is not always the case. There are situations when severe nausea may be present without emesis and less frequently, when emesis may be present without preceding nausea. Evidence: TAS. Frequency: Occasional (HP:0040283). (ORPHA:108)
- Anorexia (HP:0002039): Lack of desire to eat (loss of appetite). Evidence: TAS. Frequency: Occasional (HP:0040283). (ORPHA:108)
- Respiratory insufficiency (HP:0002093). Evidence: TAS. Frequency: Occasional (HP:0040283). (ORPHA:108)
- Hepatomegaly (HP:0002240): Abnormally increased size of the liver. Evidence: TAS. Frequency: Frequent (HP:0040282). (ORPHA:108)
- Headache (HP:0002315): Cephalgia, or pain sensed in various parts of the head, not confined to the area of distribution of any nerve. Evidence: TAS. Frequency: Very frequent (HP:0040281). (ORPHA:108)
- Recurrent infections (HP:0002719): Increased susceptibility to infections as manifested by repeated bouts of infection. Evidence: TAS. Frequency: Frequent (HP:0040282). (ORPHA:108)
- Arthralgia (HP:0002829): Joint pain. Evidence: TAS. Frequency: Frequent (HP:0040282). (ORPHA:108)
- Myalgia (HP:0003326): Pain in muscle. Evidence: TAS. Frequency: Frequent (HP:0040282). (ORPHA:108)
- Venous thrombosis (HP:0004936): Formation of a blood clot (thrombus) inside a vein, causing the obstruction of blood flow. Evidence: TAS. Frequency: Occasional (HP:0040283). (ORPHA:108)
- Disseminated intravascular coagulation (HP:0005521): Disseminated intravascular coagulation is characterized by the widespread activation of coagulation, which results in the intravascular formation of fibrin and ultimately thrombotic occlusion of small and midsize vessels. Evidence: TAS. Frequency: Occasional (HP:0040283). (ORPHA:108)
- Fatigue (HP:0012378): A subjective feeling of tiredness characterized by a lack of energy and motivation. Evidence: TAS. Frequency: Frequent (HP:0040282). (ORPHA:108)
- Cough (HP:0012735): A sudden, audible expulsion of air from the lungs through a partially closed glottis, preceded by inhalation. Evidence: TAS. Frequency: Frequent (HP:0040282). (ORPHA:108)
- Hypercoagulability (HP:0100724): An abnormality of coagulation associated with an increased risk of thrombosis. Evidence: TAS. Frequency: Occasional (HP:0040283). (ORPHA:108)
- Recurrent pharyngitis (HP:0100776): Increased susceptibility to pharyngitis, as manifested by recurrent episodes of pharyngeal infection that are unusual in frequency or severity for a healthy individual of the same age. Evidence: TAS. Frequency: Occasional (HP:0040283). (ORPHA:108)